Phenotypes associated with the disease autosomal recessive nonsyndromic hearing loss 22 (OMIM:607039, an entry in Online Mendelian Inheritance in Man):
- Sensorineural hearing impairment (HP:0000407, a Human Phenotype Ontology term): A type of hearing impairment in one or both ears related to an abnormal functionality of the cochlear nerve. Evidence: TAS. (OMIM:607039)
- Autosomal recessive inheritance (HP:0000007, a Human Phenotype Ontology term): A mode of inheritance that is observed for traits related to a gene encoded on one of the autosomes (i.e., the human chromosomes 1-22) in which a trait manifests in individuals with two pathogenic alleles, either homozygotes (two copies of the same mutant allele) or compound heterozygotes (whereby each copy of a gene has a distinct mutant allele). Evidence: TAS. (OMIM:607039)